Phenotypes associated with the disease Wolfram syndrome (ORPHA:3463):
- Sensorineural hearing impairment (HP:0000407): A type of hearing impairment in one or both ears related to an abnormal functionality of the cochlear nerve. Evidence: TAS. Frequency: Very frequent (HP:0040281). (ORPHA:3463)
- Optic atrophy (HP:0000648): Atrophy of the optic nerve. Optic atrophy results from the death of the retinal ganglion cell axons that comprise the optic nerve and manifesting as a pale optic nerve on fundoscopy. Evidence: TAS. Frequency: Very frequent (HP:0040281). (ORPHA:3463)
- Diabetes mellitus (HP:0000819): A group of abnormalities characterized by hyperglycemia and glucose intolerance. Evidence: TAS. Frequency: Very frequent (HP:0040281). (ORPHA:3463)
- Diabetes insipidus (HP:0000873): A state of excessive water intake and hypotonic (dilute) polyuria. Diabetes insipidus may be due to failure of vasopressin (AVP) release (central or neurogenic diabetes insipidus) or to a failure of the kidney to respond to AVP (nephrogenic diabetes insipidus). Evidence: TAS. Frequency: Very frequent (HP:0040281). (ORPHA:3463)
- Polydipsia (HP:0001959): Excessive thirst manifested by excessive fluid intake. Evidence: TAS. Frequency: Very frequent (HP:0040281). (ORPHA:3463)
- Recurrent urinary tract infections (HP:0000010): Repeated infections of the urinary tract. Evidence: TAS. Frequency: Frequent (HP:0040282). (ORPHA:3463)
- Abnormality of the urinary system (HP:0000079): An abnormality of the urinary system. Evidence: TAS. Frequency: Frequent (HP:0040282). (ORPHA:3463)
- Nephropathy (HP:0000112): A nonspecific term referring to disease or damage of the kidneys. Evidence: TAS. Frequency: Frequent (HP:0040282). (ORPHA:3463)
- Nystagmus (HP:0000639): Rhythmic, involuntary oscillations of one or both eyes related to abnormality in fixation, conjugate gaze, or vestibular mechanisms. Evidence: TAS. Frequency: Frequent (HP:0040282). (ORPHA:3463)
- Seizure (HP:0001250): A seizure is an intermittent abnormality of nervous system physiology characterized by a transient occurrence of signs and/or symptoms due to abnormal excessive or synchronous neuronal activity in the brain. Evidence: TAS. Frequency: Frequent (HP:0040282). (ORPHA:3463)
- Ataxia (HP:0001251): Ataxia refers to impaired coordination of voluntary muscle movement. Cerebellar ataxia refers to ataxia due to dysfunction of the cerebellum. This causes a variety of elementary neurological deficits including asynergy (lack of coordination between muscles, limbs and joints), dysmetria (lack of ability to judge distances that can lead to under- or overshoot in grasping movements), and dysdiadochokinesia (inability to perform rapid movements requiring antagonizing muscle groups to be switched on and off repeatedly). Evidence: TAS. Frequency: Frequent (HP:0040282). (ORPHA:3463)
- Dysarthria (HP:0001260): Dysarthric speech is a general description referring to a neurological speech disorder characterized by poor articulation. Depending on the involved neurological structures, dysarthria may be further classified as spastic, flaccid, ataxic, hyperkinetic and hypokinetic, or mixed. Evidence: TAS. Frequency: Frequent (HP:0040282). (ORPHA:3463)
- Feeding difficulties in infancy (HP:0008872): Impaired feeding performance of an infant as manifested by difficulties such as weak and ineffective sucking, brief bursts of sucking, and falling asleep during sucking. There may be difficulties with chewing or maintaining attention. Evidence: TAS. Frequency: Frequent (HP:0040282). (ORPHA:3463)
- Abnormal mesentery morphology (HP:0100016): Folds of membranous tissue (peritoneum, mesothelium) attached to the wall of the abdomen and enclosing viscera. Examples include the mesentery for the small intestine; the transverse mesocolon, which attaches the transverse portion of the colon to the back wall of the abdomen; and the mesosigmoid, which enfolds the sigmoid portion of the colon. Cells of the same embryologic origin also surround the other organs of the body such as the lungs (pleura) or the heart (pericardium). Evidence: TAS. Frequency: Frequent (HP:0040282). (ORPHA:3463)
- Dysuria (HP:0100518): Painful or difficult urination. Evidence: TAS. Frequency: Frequent (HP:0040282). (ORPHA:3463)
- Male hypogonadism (HP:0000026): Decreased functionality of the male gonad, i.e., of the testis, with reduced spermatogenesis or testosterone synthesis. Evidence: TAS. Frequency: Occasional (HP:0040283). (ORPHA:3463)
- Hypogonadism (HP:0000135): A decreased functionality of the gonad. Evidence: TAS. Frequency: Occasional (HP:0040283). (ORPHA:3463)
- Glaucoma (HP:0000501): Glaucoma refers loss of retinal ganglion cells in a characteristic pattern of optic neuropathy usually associated with increased intraocular pressure. Evidence: TAS. Frequency: Occasional (HP:0040283). (ORPHA:3463)
- Ophthalmoplegia (HP:0000602): Paralysis of one or more extraocular muscles that are responsible for eye movements. Evidence: TAS. Frequency: Occasional (HP:0040283). (ORPHA:3463)
- Atypical behavior (HP:0000708): Atypical behavior is an abnormality in a person's actions that can be controlled or modulated by the will of the individual. While abnormal behaviors can be difficult to control, they are distinct from other abnormal actions that cannot be affected by the individual's will. Evidence: TAS. Frequency: Occasional (HP:0040283). (ORPHA:3463)
- Dementia (HP:0000726): A loss of global cognitive ability of sufficient amount to interfere with normal social or occupational function. Dementia represents a loss of previously present cognitive abilities, generally in adults, and can affect memory, thinking, language, judgment, and behavior. Evidence: TAS. Frequency: Occasional (HP:0040283). (ORPHA:3463)
- Hallucinations (HP:0000738): Perceptions in a conscious and awake state that, in the absence of external stimuli, have qualities of real perception. These perceptions are vivid, substantial, and located in external objective space. Evidence: TAS. Frequency: Occasional (HP:0040283). (ORPHA:3463)
- Delayed puberty (HP:0000823): Passing the age when puberty normally occurs with no physical or hormonal signs of the onset of puberty. Evidence: TAS. Frequency: Occasional (HP:0040283). (ORPHA:3463)
- Intellectual disability (HP:0001249): The term intellectual disability or intellectual developmental disorder is used to describe significantly sub-average intellectual and adaptive functioning based on clinical assessment and as measured by individually administered, appropriately normed, standardized and validated tests of intellectual functioning and adaptive behavior, with onset during the developmental period from infancy through adolescence. Evidence: TAS. Frequency: Occasional (HP:0040283). (ORPHA:3463)
- Joint stiffness (HP:0001387): Joint stiffness is a perceived sensation of tightness in a joint or joints when attempting to move them after a period of inactivity. Joint stiffness typically subsides over time. Evidence: TAS. Frequency: Occasional (HP:0040283). (ORPHA:3463)
- Cardiomyopathy (HP:0001638): A myocardial disorder in which the heart muscle is structurally and functionally abnormal, in the absence of coronary artery disease, hypertension, valvular disease and congenital heart disease sufficient to cause the observed myocardial abnormality. Evidence: TAS. Frequency: Occasional (HP:0040283). (ORPHA:3463)
- Anemia (HP:0001903): A reduction in erythrocytes volume or hemoglobin concentration. Evidence: TAS. Frequency: Occasional (HP:0040283). (ORPHA:3463)
- Constipation (HP:0002019): Infrequent or difficult evacuation of feces. Evidence: TAS. Frequency: Occasional (HP:0040283). (ORPHA:3463)
- Malabsorption (HP:0002024): Impaired ability to absorb one or more nutrients from the intestine. Evidence: TAS. Frequency: Occasional (HP:0040283). (ORPHA:3463)
- Respiratory insufficiency (HP:0002093). Evidence: TAS. Frequency: Occasional (HP:0040283). (ORPHA:3463)
- Cerebral cortical atrophy (HP:0002120): Atrophy of the cortex of the cerebrum. Evidence: TAS. Frequency: Occasional (HP:0040283). (ORPHA:3463)
- Gastrointestinal hemorrhage (HP:0002239): Hemorrhage affecting the gastrointestinal tract. Evidence: TAS. Frequency: Occasional (HP:0040283). (ORPHA:3463)
- Sleep disturbance (HP:0002360): An abnormal pattern in the quality, quantity, or characteristics of sleep. Evidence: TAS. Frequency: Occasional (HP:0040283). (ORPHA:3463)
- Developmental regression (HP:0002376): Loss of developmental skills, as manifested by loss of developmental milestones. Evidence: TAS. Frequency: Occasional (HP:0040283). (ORPHA:3463)
- Gastric ulcer (HP:0002592): An ulcer, that is, an erosion of an area of the gastric mucous membrane. Evidence: TAS. Frequency: Occasional (HP:0040283). (ORPHA:3463)
- Central apnea (HP:0002871): Apnea resulting from depression of the respiratory centers in the medulla oblongata. There is a lack of respiratory effort rather than obstruction of airflow. Evidence: TAS. Frequency: Occasional (HP:0040283). (ORPHA:3463)
- Myopathy (HP:0003198): A disorder of muscle unrelated to impairment of innervation or neuromuscular junction. Evidence: TAS. Frequency: Occasional (HP:0040283). (ORPHA:3463)
- Peripheral neuropathy (HP:0009830): Peripheral neuropathy is a general term for any disorder of the peripheral nervous system. The main clinical features used to classify peripheral neuropathy are distribution, type (mainly demyelinating versus mainly axonal), duration, and course. Evidence: TAS. Frequency: Occasional (HP:0040283). (ORPHA:3463)
- Abnormal autonomic nervous system physiology (HP:0012332): A functional abnormality of the autonomic nervous system. Evidence: TAS. Frequency: Occasional (HP:0040283). (ORPHA:3463)